Phenotypes associated with the disease Silver-Russell syndrome due to maternal uniparental disomy of chromosome 11 (ORPHA:231147):
- Triangular face (HP:0000325): Facial contour, as viewed from the front, triangular in shape, with breadth at the temples and tapering to a narrow chin. Evidence: TAS. Frequency: Frequent (HP:0040282). (ORPHA:231147)
- Small for gestational age (HP:0001518): Smaller than normal size according to sex and gestational age related norms, defined as a weight below the 10th percentile for the gestational age. Evidence: TAS. Frequency: Frequent (HP:0040282). (ORPHA:231147)
- Frontal bossing (HP:0002007): Bilateral bulging of the lateral frontal bone prominences with relative sparing of the midline. Evidence: TAS. Frequency: Frequent (HP:0040282). (ORPHA:231147)
- Clinodactyly of the 5th finger (HP:0004209): Clinodactyly refers to a bending or curvature of the fifth finger in the radial direction (i.e., towards the 4th finger). Evidence: TAS. Frequency: Frequent (HP:0040282). (ORPHA:231147)
- Cleft palate (HP:0000175): Cleft palate is a developmental defect of the palate resulting from a failure of fusion of the palatine processes and manifesting as a separation of the roof of the mouth (soft and hard palate). Evidence: TAS. Frequency: Occasional (HP:0040283). (ORPHA:231147)
- Facial asymmetry (HP:0000324): An abnormal difference between the left and right sides of the face. Evidence: TAS. Frequency: Occasional (HP:0040283). (ORPHA:231147)
- Abnormality of the skeletal system (HP:0000924): An abnormality of the skeletal system. Evidence: TAS. Frequency: Occasional (HP:0040283). (ORPHA:231147)
- Hyperhidrosis (HP:0000975): Abnormal excessive perspiration (sweating) despite the lack of appropriate stimuli like hot and humid weather. Evidence: TAS. Frequency: Occasional (HP:0040283). (ORPHA:231147)
- Global developmental delay (HP:0001263): A delay in the achievement of motor or mental milestones in the domains of development of a child, including motor skills, speech and language, cognitive skills, and social and emotional skills. This term should only be used to describe children younger than five years of age. Evidence: TAS. Frequency: Occasional (HP:0040283). (ORPHA:231147)
- Intrauterine growth retardation (HP:0001511): An abnormal restriction of fetal growth with fetal weight below the tenth percentile for gestational age. Evidence: TAS. Frequency: Occasional (HP:0040283). (ORPHA:231147)
- Premature birth (HP:0001622): The birth of a baby of less than 37 weeks of gestational age. Evidence: TAS. Frequency: Occasional (HP:0040283). (ORPHA:231147)
- Abnormal heart morphology (HP:0001627): Any structural anomaly of the heart. Evidence: TAS. Frequency: Occasional (HP:0040283). (ORPHA:231147)
- Hypoglycemia (HP:0001943): A decreased concentration of glucose in the blood. Evidence: TAS. Frequency: Occasional (HP:0040283). (ORPHA:231147)
- Delayed gross motor development (HP:0002194): A type of motor delay characterized by a delay in acquiring the ability to control the large muscles of the body for walking, running, sitting, and crawling. Evidence: TAS. Frequency: Occasional (HP:0040283). (ORPHA:231147)
- External genital hypoplasia (HP:0003241): Underdevelopment of part or all of the external reproductive organs. Evidence: TAS. Frequency: Occasional (HP:0040283). (ORPHA:231147)
- Secondary microcephaly (HP:0005484): Head circumference which falls below 2 standard deviations below the mean for age and gender because of insufficient head growth after birth. Evidence: TAS. Frequency: Occasional (HP:0040283). (ORPHA:231147)
- Feeding difficulties in infancy (HP:0008872): Impaired feeding performance of an infant as manifested by difficulties such as weak and ineffective sucking, brief bursts of sucking, and falling asleep during sucking. There may be difficulties with chewing or maintaining attention. Evidence: TAS. Frequency: Occasional (HP:0040283). (ORPHA:231147)
- Gastrojejunal tube feeding in infancy (HP:0030884): Feeding problem necessitating gastrojejunal tube feeding. Evidence: TAS. Frequency: Occasional (HP:0040283). (ORPHA:231147)
- Asymmetric growth (HP:0100555): A growth pattern that displays an abnormal difference between the left and the right side. Evidence: TAS. Frequency: Occasional (HP:0040283). (ORPHA:231147)
- Lower limb asymmetry (HP:0100559): A difference in length or diameter between the left and right leg. Evidence: TAS. Frequency: Occasional (HP:0040283). (ORPHA:231147)